Phenotypes associated with the disease lattice corneal dystrophy type I (OMIM:122200):
- Recurrent corneal erosions (HP:0000495): The presence of recurrent corneal epithelial erosions. Although most corneal epithelial defects heal quickly, some may show recurrent ulcerations. Evidence: IEA. (OMIM:122200)
- Progressive visual loss (HP:0000529): A reduction of previously attained ability to see. Evidence: IEA. (OMIM:122200)
- Autosomal dominant inheritance (HP:0000006): A mode of inheritance that is observed for traits related to a gene encoded on one of the autosomes (i.e., the human chromosomes 1-22) in which a trait manifests in heterozygotes. In the context of medical genetics, an autosomal dominant disorder is caused when a single copy of the mutant allele is present. Males and females are affected equally, and can both transmit the disorder with a risk of 50% for each child of inheriting the mutant allele. Evidence: IEA. (OMIM:122200)
- Lattice corneal dystrophy (HP:0001149): The presence of fine, branching linear opacities in Bowman's layer in the central area that may spread to the periphery in the clinical course. The deep corneal stroma may be involved but the process does not reach Descemet's membrane. Recurrent corneal erosion may occur. Histologic examination reveals amyloid deposits in the collagen fibers of the cornea. Evidence: TAS. (OMIM:122200)